- Small intestine carcinoid (HP:0006722). Evidence: TAS. Frequency: Obligate (HP:0040280). (ORPHA:100078)
- Dermatological manifestations of systemic disorders (HP:0001005). Evidence: TAS. Frequency: Very frequent (HP:0040281). (ORPHA:100078)
- Intermittent diarrhea (HP:0002254): Repeated episodes of diarrhea separated by periods without diarrhea. Evidence: TAS. Frequency: Very frequent (HP:0040281). (ORPHA:100078)
- Episodic abdominal pain (HP:0002574): An intermittent form of abdominal pain. Evidence: TAS. Frequency: Very frequent (HP:0040281). (ORPHA:100078)
- Increased serum serotonin (HP:0003144): A increased concentration of serotonin in the blood. Evidence: TAS. Frequency: Very frequent (HP:0040281). (ORPHA:100078)
- Weight loss (HP:0001824): Reduction of total body weight. Evidence: TAS. Frequency: Frequent (HP:0040282). (ORPHA:100078)
- Iron deficiency anemia (HP:0001891). Evidence: TAS. Frequency: Frequent (HP:0040282). (ORPHA:100078)
- Nausea (HP:0002018): A sensation of unease in the stomach together with an urge to vomit. Evidence: TAS. Frequency: Frequent (HP:0040282). (ORPHA:100078)
- Episodic vomiting (HP:0002572): Paroxysmal, recurrent episodes of vomiting. Evidence: TAS. Frequency: Frequent (HP:0040282). (ORPHA:100078)
- Lymphadenopathy (HP:0002716): Enlargement (swelling) of a lymph node. Evidence: TAS. Frequency: Frequent (HP:0040282). (ORPHA:100078)
- Elevated circulating hepatic transaminase concentration (HP:0002910): Elevations of the levels of SGOT and SGPT in the serum. SGOT (serum glutamic oxaloacetic transaminase) and SGPT (serum glutamic pyruvic transaminase) are transaminases primarily found in the liver and heart and are released into the bloodstream as the result of liver or heart damage. SGOT and SGPT are used clinically mainly as markers of liver damage. Evidence: TAS. Frequency: Frequent (HP:0040282). (ORPHA:100078)
- Elevated serum acid phosphatase (HP:0003148). Evidence: TAS. Frequency: Frequent (HP:0040282). (ORPHA:100078)
- Gastrointestinal obstruction (HP:0004796). Evidence: TAS. Frequency: Frequent (HP:0040282). (ORPHA:100078)
- Functional intestinal obstruction (HP:0005249). Evidence: TAS. Frequency: Frequent (HP:0040282). (ORPHA:100078)
- Extrahepatic cholestasis (HP:0012334): Impairment of bile flow due to obstruction in large bile ducts outside the liver. Evidence: TAS. Frequency: Frequent (HP:0040282). (ORPHA:100078)
- Chronic fatigue (HP:0012432): Subjective feeling of tiredness characterized by a lack of energy and motivation that persists for six months or longer. Evidence: TAS. Frequency: Frequent (HP:0040282). (ORPHA:100078)
- Arterial occlusion (HP:0025324): Blockage of blood flow through an artery. Evidence: TAS. Frequency: Frequent (HP:0040282). (ORPHA:100078)
- Abnormal bowel sounds (HP:0030142): An anomaly of the amount or nature of abdominal sounds. Abdominal sounds (bowel sounds) are made by the movement of the intestines as they promote passage of abdominal contents by peristalsis. Evidence: TAS. Frequency: Frequent (HP:0040282). (ORPHA:100078)
- Intestinal fistula (HP:0100819): An abnormal connection between the gut and another hollow organ, such as the bladder, urethra, vagina, or other regions of the gastrointestinal tract. Evidence: TAS. Frequency: Occasional (HP:0040283). (ORPHA:100078)
- Hydronephrosis (HP:0000126): Severe distention of the kidney with dilation of the renal pelvis and calices. Evidence: TAS. Frequency: Very rare (HP:0040284). (ORPHA:100078)
- Edema (HP:0000969): An abnormal accumulation of fluid beneath the skin, or in one or more cavities of the body. Evidence: TAS. Frequency: Very rare (HP:0040284). (ORPHA:100078)
- Hepatic failure (HP:0001399). Evidence: TAS. Frequency: Very rare (HP:0040284). (ORPHA:100078)
- Pulmonic stenosis (HP:0001642): A narrowing of the right ventricular outflow tract that can occur at the pulmonary valve (valvular stenosis), below the pulmonary valve (infundibular stenosis), or above the pulmonary valve (supravalvar stenosis). Evidence: TAS. Frequency: Very rare (HP:0040284). (ORPHA:100078)
- Right ventricular failure (HP:0001708): Reduced ability of the right ventricle to perform its function (to receive blood from the right atrium and to eject blood into the pulmonary artery), often leading to pitting peripheral edema, ascites, and hepatomegaly. Evidence: TAS. Frequency: Very rare (HP:0040284). (ORPHA:100078)
- Palpitations (HP:0001962): A sensation that the heart is pounding or racing, which is a non-specific sign but may be a manifestation of arrhythmia. Evidence: TAS. Frequency: Very rare (HP:0040284). (ORPHA:100078)
- Zollinger-Ellison syndrome (HP:0002044): A condition in which there is increased production of gastrin by a gastrin-secreting tumor (usually located in the pancreas, duodenum, or abdominal lymph nodes) that stimulates the gastric mucosa to maximal activity, with consequent gastrointestinal mucosal ulceration. Evidence: TAS. Frequency: Very rare (HP:0040284). (ORPHA:100078)
- Hypotension (HP:0002615): Low Blood Pressure, vascular hypotension. Evidence: TAS. Frequency: Very rare (HP:0040284). (ORPHA:100078)
- Tricuspid stenosis (HP:0010446): A narrowing of the orifice of the tricuspid valve of the heart. Evidence: TAS. Frequency: Very rare (HP:0040284). (ORPHA:100078)
- Arrhythmia (HP:0011675): Any cardiac rhythm other than the normal sinus rhythm. Such a rhythm may be either of sinus or ectopic origin and either regular or irregular. An arrhythmia may be due to a disturbance in impulse formation or conduction or both. Evidence: TAS. Frequency: Very rare (HP:0040284). (ORPHA:100078)
- Abnormal bronchus morphology (HP:0025426): Any structural anomaly of the bronchi, i.e., of the airways leading from the trachea to the lungs. Evidence: TAS. Frequency: Very rare (HP:0040284). (ORPHA:100078)
- Cardiogenic shock (HP:0030149): Severely decreased cardiac output with evidence of inadequate end-organ perfusion (i.e., tissue hypoxia) in the presence of adequate intravascular volume. Evidence: TAS. Frequency: Very rare (HP:0040284). (ORPHA:100078)
These phenotypes are associated with the disease Ileal neuroendocrine tumor (ORPHA:100078).